- Juvenile onset (HP:0003621): Onset of signs or symptoms of disease between the age of 5 and 15 years. Evidence: PCS. Frequency: 3/7. (PMID:29474921)
- Mild global developmental delay (HP:0011342): A mild delay in the achievement of motor or mental milestones in the domains of development of a child. Evidence: PCS. Frequency: 1/7. Onset: Infantile onset (HP:0003593). (PMID:29474921)
- Childhood onset (HP:0011463): Onset of disease at the age of between 1 and 5 years. Evidence: PCS. Frequency: 2/7. (PMID:29474921)
- Infantile onset (HP:0003593): Onset of signs or symptoms of disease between 28 days to one year of life. Evidence: PCS. Frequency: 2/7. (PMID:29474921)
- Autosomal recessive inheritance (HP:0000007): A mode of inheritance that is observed for traits related to a gene encoded on one of the autosomes (i.e., the human chromosomes 1-22) in which a trait manifests in individuals with two pathogenic alleles, either homozygotes (two copies of the same mutant allele) or compound heterozygotes (whereby each copy of a gene has a distinct mutant allele). Evidence: PCS. (PMID:29474921)
- Viral encephalitis (HP:0033993): An inflammation of brain parenchyma due to infection with a virus. Viral encephalitis can occur as a rare complication of common infections (eg, herpes virus infections) or can occur as a characteristic presentation of rare viruses (eg, rabies virus infection). Encephalitis may be the only neurologic manifestation of infection, or may occur in association with meningitis, myelitis, radiculitis, or neuritis. Viral encephalitis is associated with neurological dysfunction. Evidence: PCS. Frequency: 7/7. Onset: Juvenile onset (HP:0003621). (PMID:29474921)
- Intrauterine growth retardation (HP:0001511): An abnormal restriction of fetal growth with fetal weight below the tenth percentile for gestational age. Evidence: PCS. Frequency: 1/7. Onset: Fetal onset (HP:0011461). (PMID:29474921)
These phenotypes are associated with the disease encephalitis, acute, infection (viral)-induced, susceptibility to, 11 (OMIM:619441).